Phenotypes associated with the disease Non-syndromic unicoronal craniosynostosis (ORPHA:620102):
- Abnormal forehead morphology (HP:0000290): An anomaly of the forehead. Evidence: TAS. Frequency: Frequent (HP:0040282). (ORPHA:620102)
- Torticollis (HP:0000473): Involuntary contractions of the neck musculature resulting in an abnormal posture of or abnormal movements of the head. Evidence: TAS. Frequency: Frequent (HP:0040282). (ORPHA:620102)
- Astigmatism (HP:0000483): A type of refraction error associated with abnormal curvatures on the anterior and/or posterior surface of the cornea. Evidence: TAS. Frequency: Frequent (HP:0040282). (ORPHA:620102)
- Strabismus (HP:0000486): A misalignment of the eyes so that the visual axes deviate from bifoveal fixation. The classification of strabismus may be based on a number of features including the relative position of the eyes, whether the deviation is latent or manifest, intermittent or constant, concomitant or otherwise and according to the age of onset and the relevance of any associated refractive error. Evidence: TAS. Frequency: Frequent (HP:0040282). (ORPHA:620102)
- Amblyopia (HP:0000646): Reduced visual acuity that is uncorrectable by lenses in the absence of detectable anatomic defects in the eye or visual pathways. Evidence: TAS. Frequency: Frequent (HP:0040282). (ORPHA:620102)
- Frontal bossing (HP:0002007): Bilateral bulging of the lateral frontal bone prominences with relative sparing of the midline. Evidence: TAS. Frequency: Frequent (HP:0040282). (ORPHA:620102)
- Craniofacial asymmetry (HP:0004484): Asymmetry of the bones of the skull and the face. Evidence: TAS. Frequency: Frequent (HP:0040282). (ORPHA:620102)
- Epiblepharon (HP:0011225): Redundant eyelid skin pressing the eyelashes against the cornea and/or conjunctiva. Evidence: TAS. Frequency: Frequent (HP:0040282). (ORPHA:620102)
- Abnormal morphology of bony orbit of skull (HP:3000030): An abnormality of an orbit of skull. Evidence: TAS. Frequency: Frequent (HP:0040282). (ORPHA:620102)
- Esotropia (HP:0000565): A form of strabismus with one or both eyes turned inward ('crossed') to a relatively severe degree, usually defined as 10 diopters or more. Evidence: TAS. Frequency: Occasional (HP:0040283). (ORPHA:620102)
- Exotropia (HP:0000577): A form of strabismus with one or both eyes deviated outward. Evidence: TAS. Frequency: Occasional (HP:0040283). (ORPHA:620102)
- Anisometropia (HP:0012803): Inequality of refractive power of the two eyes. Evidence: TAS. Frequency: Occasional (HP:0040283). (ORPHA:620102)
- Lagophthalmos (HP:0030001): A condition in which the eyelids do not close to cover the eye completely. Evidence: TAS. Frequency: Occasional (HP:0040283). (ORPHA:620102)
- Papilledema (HP:0001085): Papilledema refers to edema (swelling) of the optic disc secondary to any factor which increases cerebral spinal fluid pressure. Evidence: TAS. Frequency: Very rare (HP:0040284). (ORPHA:620102)